Phenotypes associated with the disease Psoriasis-related juvenile idiopathic arthritis (ORPHA:85436):
- Abnormality of tumor necrosis factor secretion (HP:0011118): An abnormality in the production or cellular release of tumor necrosis factor. Evidence: TAS. Frequency: Very frequent (HP:0040281). (ORPHA:85436)
- Pruritus (HP:0000989): Pruritus is an itch or a sensation that makes a person want to scratch. This term refers to an abnormally increased disposition to experience pruritus. Evidence: TAS. Frequency: Frequent (HP:0040282). (ORPHA:85436)
- Arthritis (HP:0001369): Inflammation of a joint. Evidence: TAS. Frequency: Frequent (HP:0040282). (ORPHA:85436)
- Nail pits (HP:0001803): Small (typically about 1 mm or less in size) depressions on the dorsal nail surface. Evidence: TAS. Frequency: Frequent (HP:0040282). (ORPHA:85436)
- Arthralgia (HP:0002829): Joint pain. Evidence: TAS. Frequency: Frequent (HP:0040282). (ORPHA:85436)
- Autoimmunity (HP:0002960): The occurrence of an immune reaction against the organism's own cells or tissues. Evidence: TAS. Frequency: Frequent (HP:0040282). (ORPHA:85436)
- Antinuclear antibody positivity (HP:0003493): The presence of autoantibodies in the serum that react against nuclei or nuclear components. Evidence: TAS. Frequency: Frequent (HP:0040282). (ORPHA:85436)
- Psoriasiform dermatitis (HP:0003765): A skin abnormality characterized by redness and irritation, with thick, red skin that displays flaky, silver-white patches (scales). Evidence: TAS. Frequency: Frequent (HP:0040282). (ORPHA:85436)
- Polyarticular arthritis (HP:0005764). Evidence: TAS. Frequency: Frequent (HP:0040282). (ORPHA:85436)
- Finger dactylitis (HP:0031090): Fingers appear swollen and plump owing to inflammation of the complete finger. Evidence: TAS. Frequency: Frequent (HP:0040282). (ORPHA:85436)
- Toe dactylitis (HP:0031091): Toes appear swollen and plump owing to inflammation of the complete toe. Evidence: TAS. Frequency: Frequent (HP:0040282). (ORPHA:85436)
- Oligoarthritis (HP:0040313): A type of arthritis that affects up to four joints in the first six months of disease. Evidence: TAS. Frequency: Frequent (HP:0040282). (ORPHA:85436)
- Enthesitis (HP:0100686). Evidence: TAS. Frequency: Frequent (HP:0040282). (ORPHA:85436)
- Uveitis (HP:0000554): Inflammation of one or all portions of the uveal tract. Evidence: TAS. Frequency: Occasional (HP:0040283). (ORPHA:85436)
- Skin rash (HP:0000988): A red eruption of the skin. Evidence: TAS. Frequency: Occasional (HP:0040283). (ORPHA:85436)
- Limitation of joint mobility (HP:0001376): A reduction in the freedom of movement of one or more joints. Evidence: TAS. Frequency: Occasional (HP:0040283). (ORPHA:85436)
- Abnormality of the knee (HP:0002815): An abnormality of the knee joint or surrounding structures. Evidence: TAS. Frequency: Occasional (HP:0040283). (ORPHA:85436)
- Abnormality of the wrist (HP:0003019): Abnormality of the wrist, the structure connecting the hand and the forearm. Evidence: TAS. Frequency: Occasional (HP:0040283). (ORPHA:85436)
- Abnormal shoulder morphology (HP:0003043): An abnormality of the shoulder, which is defined as the structures surrounding the shoulder joint where the humerus attaches to the scapula. Evidence: TAS. Frequency: Occasional (HP:0040283). (ORPHA:85436)
- Generalized morning stiffness (HP:0005197): A sensation of stiffness in the joints that occurs following waking up in the morning. Evidence: TAS. Frequency: Occasional (HP:0040283). (ORPHA:85436)
- Reduced visual acuity (HP:0007663). Evidence: TAS. Frequency: Occasional (HP:0040283). (ORPHA:85436)
- Anterior uveitis (HP:0012122): Inflammation of the uveal tract in which the primary site of inflammation is the anterior chamber. Evidence: TAS. Frequency: Occasional (HP:0040283). (ORPHA:85436)
- Malar rash (HP:0025300): An erythematous (red), flat facial rash that affects the skin in the malar area (over the cheekbones) and extends over the bridge of the nose. Evidence: TAS. Frequency: Occasional (HP:0040283). (ORPHA:85436)
- Psoriasiform lesion (HP:0025526): A skin lesions that resembles the lesions observed in psoriasis, viz., an erythematous plaque covered by fine silvery scales. Psoriasiform lesions can be observed in psoriasis as well as in other conditions including allergic contact dermatitis, seborrhoeic dermatitis, Atopic dermatitis, pityriasis rubra, and lichen simplex chronicus. Evidence: TAS. Frequency: Occasional (HP:0040283). (ORPHA:85436)
- Iridocyclitis (HP:0001094): A type of anterior uveitis, in which there is Inflammation of the iris and the ciliary body. Evidence: TAS. Frequency: Very rare (HP:0040284). (ORPHA:85436)
- Iritis (HP:0001101): Inflammation of the iris. Evidence: TAS. Frequency: Very rare (HP:0040284). (ORPHA:85436)
- Onycholysis (HP:0001806): Detachment of the nail from the nail bed. Evidence: TAS. Frequency: Very rare (HP:0040284). (ORPHA:85436)
- Abnormality of the temporomandibular joint (HP:0010754): An anomaly of the temporomandibular joint. Evidence: TAS. Frequency: Very rare (HP:0040284). (ORPHA:85436)
- Sacroiliac arthritis (HP:0012317): Inflammation of the sacroiliac joint, generally accompanied by lower back pain. Evidence: TAS. Frequency: Very rare (HP:0040284). (ORPHA:85436)